- CSF pleocytosis (HP:0012229): An increased white blood cell count in the cerebrospinal fluid. Evidence: TAS. Frequency: Very frequent (HP:0040281). (ORPHA:297)
- Decreased total leukocyte count (HP:0001882): An abnormal decreased number of leukocytes in the blood. Evidence: TAS. Frequency: Frequent (HP:0040282). (ORPHA:297)
- Nausea (HP:0002018): A sensation of unease in the stomach together with an urge to vomit. Evidence: TAS. Frequency: Frequent (HP:0040282). (ORPHA:297)
- Anorexia (HP:0002039): Lack of desire to eat (loss of appetite). Evidence: TAS. Frequency: Frequent (HP:0040282). (ORPHA:297)
- Headache (HP:0002315): Cephalgia, or pain sensed in various parts of the head, not confined to the area of distribution of any nerve. Evidence: TAS. Frequency: Frequent (HP:0040282). (ORPHA:297)
- Arthralgia (HP:0002829): Joint pain. Evidence: TAS. Frequency: Frequent (HP:0040282). (ORPHA:297)
- Myalgia (HP:0003326): Pain in muscle. Evidence: TAS. Frequency: Frequent (HP:0040282). (ORPHA:297)
- Abnormal circulating cytokine concentration (HP:0011112): Abnormality of the cytokine levels in the blood, i.e., an abnormality of any of the non-antibody proteins made by inflammatory leukocytes and some non-leukocytic cells that affect the behavior of other cells. Evidence: TAS. Frequency: Frequent (HP:0040282). (ORPHA:297)
- Fatigue (HP:0012378): A subjective feeling of tiredness characterized by a lack of energy and motivation. Evidence: TAS. Frequency: Frequent (HP:0040282). (ORPHA:297)
- Viremia (HP:0020071): The presence of virus in the blood. Evidence: TAS. Frequency: Frequent (HP:0040282). (ORPHA:297)
- Tinnitus (HP:0000360): Tinnitus is an auditory perception that can be described as the experience of sound, in the ear or in the head, in the absence of external acoustic stimulation. Evidence: TAS. Frequency: Occasional (HP:0040283). (ORPHA:297)
- Hearing impairment (HP:0000365): A decreased magnitude of the sensory perception of sound. Evidence: TAS. Frequency: Occasional (HP:0040283). (ORPHA:297)
- Visual impairment (HP:0000505): Visual impairment (or vision impairment) is vision loss (of a person) to such a degree as to qualify as an additional support need through a significant limitation of visual capability resulting from either disease, trauma, or congenital or degenerative conditions that cannot be corrected by conventional means, such as refractive correction, medication, or surgery. Evidence: TAS. Frequency: Occasional (HP:0040283). (ORPHA:297)
- Ophthalmoplegia (HP:0000602): Paralysis of one or more extraocular muscles that are responsible for eye movements. Evidence: TAS. Frequency: Occasional (HP:0040283). (ORPHA:297)
- Photophobia (HP:0000613): Excessive sensitivity to light with the sensation of discomfort or pain in the eyes due to exposure to bright light. Evidence: TAS. Frequency: Occasional (HP:0040283). (ORPHA:297)
- Atypical behavior (HP:0000708): Atypical behavior is an abnormality in a person's actions that can be controlled or modulated by the will of the individual. While abnormal behaviors can be difficult to control, they are distinct from other abnormal actions that cannot be affected by the individual's will. Evidence: TAS. Frequency: Occasional (HP:0040283). (ORPHA:297)
- Depression (HP:0000716): Frequently experiencing feelings of being down, miserable, and/or hopeless; struggling to recover from these moods; having a pessimistic outlook on the future; feeling a pervasive sense of shame; having a low self-worth; experiencing thoughts of suicide and engaging in suicidal behavior. Evidence: TAS. Frequency: Occasional (HP:0040283). (ORPHA:297)
- Personality changes (HP:0000751): An abnormal shift in patterns of thinking, acting, or feeling. Evidence: TAS. Frequency: Occasional (HP:0040283). (ORPHA:297)
- Excessive daytime somnolence (HP:0001262): A state of abnormally strong desire for sleep during the daytime. Evidence: TAS. Frequency: Occasional (HP:0040283). (ORPHA:297)
- Meningitis (HP:0001287): Inflammation of the meninges. Evidence: TAS. Frequency: Occasional (HP:0040283). (ORPHA:297)
- Abnormal cranial nerve morphology (HP:0001291): Structural abnormality affecting one or more of the cranial nerves, which emerge directly from the brain stem. Evidence: TAS. Frequency: Occasional (HP:0040283). (ORPHA:297)
- Tongue fasciculations (HP:0001308): Fasciculations or fibrillation affecting the tongue muscle. Evidence: TAS. Frequency: Occasional (HP:0040283). (ORPHA:297)
- Tremor (HP:0001337): An unintentional, oscillating to-and-fro muscle movement about a joint axis. Evidence: TAS. Frequency: Occasional (HP:0040283). (ORPHA:297)
- Thrombocytopenia (HP:0001873): A reduction in the number of circulating thrombocytes. Evidence: TAS. Frequency: Occasional (HP:0040283). (ORPHA:297)
- Increased total leukocyte count (HP:0001974): An abnormal increase in the number of leukocytes in the blood. Evidence: TAS. Frequency: Occasional (HP:0040283). (ORPHA:297)
- Vomiting (HP:0002013): Forceful ejection of the contents of the stomach through the mouth by means of a series of involuntary spasmic contractions. Evidence: TAS. Frequency: Occasional (HP:0040283). (ORPHA:297)
- Dysphagia (HP:0002015): Difficulty in swallowing. Evidence: TAS. Frequency: Occasional (HP:0040283). (ORPHA:297)
- Incoordination (HP:0002311): A deficit in coordination of muscle movements. Coordination is defined as the orchestrated movement of multiple body parts as required to accomplish intended actions, like walking. Evidence: TAS. Frequency: Occasional (HP:0040283). (ORPHA:297)
- Vertigo (HP:0002321): An abnormal sensation of spinning while the body is actually stationary. Evidence: TAS. Frequency: Occasional (HP:0040283). (ORPHA:297)
- Sleep disturbance (HP:0002360): An abnormal pattern in the quality, quantity, or characteristics of sleep. Evidence: TAS. Frequency: Occasional (HP:0040283). (ORPHA:297)
- Hyperkinetic movements (HP:0002487): Motor hyperactivity with excessive movement of muscles of the body as a whole. Evidence: TAS. Frequency: Occasional (HP:0040283). (ORPHA:297)
- Skeletal muscle atrophy (HP:0003202): The presence of skeletal muscular atrophy (which is also known as amyotrophy). Evidence: TAS. Frequency: Occasional (HP:0040283). (ORPHA:297)
- Increased circulating IgG concentration (HP:0003237): An abnormally increased level of immunoglobulin G in blood. Evidence: TAS. Frequency: Occasional (HP:0040283). (ORPHA:297)
- Back pain (HP:0003418): An unpleasant sensation characterized by physical discomfort (such as pricking, throbbing, or aching) localized to the back. Evidence: TAS. Frequency: Occasional (HP:0040283). (ORPHA:297)
- Paralysis (HP:0003470): Paralysis of voluntary muscles means loss of contraction due to interruption of one or more motor pathways from the brain to the muscle fibers. Although the word paralysis is often used interchangeably to mean either complete or partial loss of muscle strength, it is preferable to use paralysis or plegia for complete or severe loss of muscle strength, and paresis for partial or slight loss. Motor paralysis results from deficits of the upper motor neurons (corticospinal, corticobulbar, or subcorticospinal). Motor paralysis is often accompanied by an impairment in the facility of movement. Evidence: TAS. Frequency: Occasional (HP:0040283). (ORPHA:297)
- Somatic sensory dysfunction (HP:0003474): An abnormality of the primary sensation that is mediated by peripheral nerves (pain, temperature, touch, vibration, joint position). The word hypoesthesia (or hypesthesia) refers to a reduction in cutaneous sensation to a specific type of testing. Evidence: TAS. Frequency: Occasional (HP:0040283). (ORPHA:297)
- Increased circulating IgM concentration (HP:0003496): An abnormally increased level of immunoglobulin M in blood. Evidence: TAS. Frequency: Occasional (HP:0040283). (ORPHA:297)
- Elevated erythrocyte sedimentation rate (HP:0003565): An increased erythrocyte sedimentation rate (ESR). The ESR is a test that measures the distance that erythrocytes have fallen after one hour in a vertical column of anticoagulated blood under the influence of gravity. The ESR is a nonspecific finding. An elevation may indicate inflammation or may be caused by any condition that elevates fibrinogen. Evidence: TAS. Frequency: Occasional (HP:0040283). (ORPHA:297)
- Reduced consciousness (HP:0004372): Abnormally diminished level of attention, responsiveness, or wakefulness. Evidence: TAS. Frequency: Occasional (HP:0040283). (ORPHA:297)
- Limb pain (HP:0009763): Chronic pain in the limbs with no clear focal etiology. Evidence: TAS. Frequency: Occasional (HP:0040283). (ORPHA:297)
- Speech apraxia (HP:0011098): A type of apraxia that is characterized by difficulty or inability to execute speech movements because of problems with coordination and motor problems, leading to incorrect articulation. An increase of errors with increasing word and phrase length may occur. Evidence: TAS. Frequency: Occasional (HP:0040283). (ORPHA:297)
- Elevated circulating C-reactive protein concentration (HP:0011227): The concentration of C-reactive protein in the blood circulation is above the upper limit of normal. Evidence: TAS. Frequency: Occasional (HP:0040283). (ORPHA:297)
- Abnormality of the vestibular nerve (HP:0011392). Evidence: TAS. Frequency: Occasional (HP:0040283). (ORPHA:297)
- Unusual CNS infection (HP:0011450): Increased susceptibility to infections of the central nervous system, as manifested by recurrent, severe, or invasive infections involving the brain, meninges, or spinal cord. This can include infections caused by opportunistic or atypical pathogens, or common pathogens presenting with unusual severity or in anatomical locations. Evidence: TAS. Frequency: Occasional (HP:0040283). (ORPHA:297)
- Abnormal autonomic nervous system physiology (HP:0012332): A functional abnormality of the autonomic nervous system. Evidence: TAS. Frequency: Occasional (HP:0040283). (ORPHA:297)
- Stiff neck (HP:0025258): A sensation of tightness in the neck when attempting to move it, especially after a period of inactivity. Neck stiffness often involves soreness and difficulty moving the neck, especially when trying to turn the head to the side. Evidence: TAS. Frequency: Occasional (HP:0040283). (ORPHA:297)
- Diminished ability to concentrate (HP:0031987): The inability to focus or concentrate on a specific task, activity, or object. The subject may find themselves unable to grasp or understand written text and re-reads frequently without understanding. Familiar tasks or activities are severely compromised due to the lack of ability to concentrate. Thinking through multi-step problems is typically very difficult or impossible, leading to avoidance of such activities. Evidence: TAS. Frequency: Occasional (HP:0040283). (ORPHA:297)
- Decreased vigilance (HP:0032044): A decrease in the ability to maintain sustained attention is characterized by reduced alertness. Evidence: TAS. Frequency: Occasional (HP:0040283). (ORPHA:297)
- Cognitive impairment (HP:0100543): Abnormal cognition is characterized by deficits in thinking, reasoning, or remembering. Evidence: TAS. Frequency: Occasional (HP:0040283). (ORPHA:297)
- Abnormal glossopharyngeal nerve morphology (HP:3000047): Any structural anomaly of the glossopharyngeal nerve, the ninth paired cranial nerve (CN IX). Evidence: TAS. Frequency: Occasional (HP:0040283). (ORPHA:297)
- Psychosis (HP:0000709): A condition characterized by changes in personality and thought patterns, often accompanied by hallucinations and delusional beliefs, is known as psychosis. Evidence: TAS. Frequency: Very rare (HP:0040284). (ORPHA:297)
- Coma (HP:0001259): The complete absence of wakefulness and consciousness, which is evident through a lack of response to any form of external stimuli. Evidence: TAS. Frequency: Very rare (HP:0040284). (ORPHA:297)
- Abnormal myocardium morphology (HP:0001637): A structural anomaly of the muscle layer of the heart wall. Evidence: TAS. Frequency: Very rare (HP:0040284). (ORPHA:297)
- Generalized-onset seizure (HP:0002197): A generalized-onset seizure is a type of seizure originating at some point within, and rapidly engaging, bilaterally distributed networks. The networks may include cortical and subcortical structures but not necessarily the entire cortex. Evidence: TAS. Frequency: Very rare (HP:0040284). (ORPHA:297)
- Elevated circulating hepatic transaminase concentration (HP:0002910): Elevations of the levels of SGOT and SGPT in the serum. SGOT (serum glutamic oxaloacetic transaminase) and SGPT (serum glutamic pyruvic transaminase) are transaminases primarily found in the liver and heart and are released into the bloodstream as the result of liver or heart damage. SGOT and SGPT are used clinically mainly as markers of liver damage. Evidence: TAS. Frequency: Very rare (HP:0040284). (ORPHA:297)
- Focal-onset seizure (HP:0007359): A focal-onset seizure is a type of seizure originating within networks limited to one hemisphere. They may be discretely localized or more widely distributed, and may originate in subcortical structures. Evidence: TAS. Frequency: Very rare (HP:0040284). (ORPHA:297)
- Facial palsy (HP:0010628): Facial nerve palsy is a dysfunction of cranial nerve VII (the facial nerve) that results in inability to control facial muscles on the affected side with weakness of the muscles of facial expression and eye closure. This can either be present in unilateral or bilateral form. Evidence: TAS. Frequency: Very rare (HP:0040284). (ORPHA:297)
- Abnormal medulla oblongata morphology (HP:0011441): An abnormality of the medulla oblongata, the lower half of the brainstem. Evidence: TAS. Frequency: Very rare (HP:0040284). (ORPHA:297)
- Myelitis (HP:0012486): Inflammation of the spinal cord. Evidence: TAS. Frequency: Very rare (HP:0040284). (ORPHA:297)
- Abnormal brainstem MRI signal intensity (HP:0012747): A deviation from normal signal on magnetic resonance imaging (MRI) of the brainstem. Evidence: TAS. Frequency: Very rare (HP:0040284). (ORPHA:297)
- Fatigable weakness of respiratory muscles (HP:0030196): A type of weakness of the muscles involved in breathing (respiration) that occurs after a muscle group is used and lessens if the muscle group has some rest. That is, there is diminution of strength with repetitive muscle actions. Evidence: TAS. Frequency: Very rare (HP:0040284). (ORPHA:297)
- Polyneuritis (HP:0031003): Simultaneous inflammation of multiple nerves. Evidence: TAS. Frequency: Very rare (HP:0040284). (ORPHA:297)
- Delirium (HP:0031258): A state of sudden and severe confusion. Evidence: TAS. Frequency: Very rare (HP:0040284). (ORPHA:297)
These phenotypes are associated with the disease Tick-borne encephalitis (ORPHA:297).